Phenotypes associated with the disease long QT syndrome 10 (OMIM:611819):
- Juvenile onset (HP:0003621): Onset of signs or symptoms of disease between the age of 5 and 15 years. Evidence: PCS. Frequency: 1/3. (PMID:17592081)
- T-wave alternans (HP:0012266): A periodic beat-to-beat variation in the amplitude or shape of the T wave in an EKG. Evidence: PCS. (PMID:17592081)
- Childhood onset (HP:0011463): Onset of disease at the age of between 1 and 5 years. Evidence: PCS. Frequency: 1/3. (PMID:17592081)
- Adult onset (HP:0003581): Onset of disease manifestations in adulthood, defined here as at the age of 16 years or later. Evidence: PCS. Frequency: 1/3. (PMID:17592081)
- Atrial fibrillation (HP:0005110): An atrial arrhythmia characterized by disorganized atrial activity without discrete P waves on the surface EKG, but instead by an undulating baseline or more sharply circumscribed atrial deflections of varying amplitude an frequency ranging from 350 to 600 per minute. Evidence: TAS. Frequency: Occasional (HP:0040283). (OMIM:611819)
- Prolonged QT interval (HP:0001657): Increased time between the start of the Q wave and the end of the T wave as measured by the electrocardiogram (EKG). Evidence: PCS. (PMID:17592081)
- Autosomal dominant inheritance (HP:0000006): A mode of inheritance that is observed for traits related to a gene encoded on one of the autosomes (i.e., the human chromosomes 1-22) in which a trait manifests in heterozygotes. In the context of medical genetics, an autosomal dominant disorder is caused when a single copy of the mutant allele is present. Males and females are affected equally, and can both transmit the disorder with a risk of 50% for each child of inheriting the mutant allele. Evidence: PCS. (PMID:17592081)
- Sudden cardiac death (HP:0001645): The heart suddenly and unexpectedly stops beating resulting in death within a short time period (generally within 1 h of symptom onset). Evidence: PCS. Frequency: 2/10. (PMID:17592081)
- Atrioventricular block (HP:0001678): Delayed or lack of conduction of atrial depolarizations through the atrioventricular node to the ventricles. Evidence: PCS. (PMID:17592081)